- Hydronephrosis (HP:0000126): Severe distention of the kidney with dilation of the renal pelvis and calices. Evidence: TAS. Frequency: Frequent (HP:0040282). (ORPHA:1780)
- Rectovaginal fistula (HP:0000143): The presence of a fistula between the vagina and the rectum. Evidence: TAS. Frequency: Frequent (HP:0040282). (ORPHA:1780)
- Narrow mouth (HP:0000160): Distance between the commissures of the mouth more than 2 SD below the mean. Alternatively, an apparently decreased width of the oral aperture (subjective). Evidence: TAS. Frequency: Very frequent (HP:0040281). (ORPHA:1780)
- Hypertelorism (HP:0000316): Interpupillary distance more than 2 SD above the mean (alternatively, the appearance of an increased interpupillary distance or widely spaced eyes). Evidence: TAS. Frequency: Very frequent (HP:0040281). (ORPHA:1780)
- Posteriorly rotated ears (HP:0000358): A type of abnormal location of the ears in which the position of the ears is characterized by posterior rotation (the superior part of the ears is rotated towards the back of the head, and the inferior part of the ears towards the front). Evidence: TAS. Frequency: Very frequent (HP:0040281). (ORPHA:1780)
- Macrotia (HP:0000400): Median longitudinal ear length greater than two standard deviations above the mean and median ear width greater than two standard deviations above the mean (objective); or, apparent increase in length and width of the pinna (subjective). Evidence: TAS. Frequency: Frequent (HP:0040282). (ORPHA:1780)
- Bulbous nose (HP:0000414): Increased volume and globular shape of the anteroinferior aspect of the nose. Evidence: TAS. Frequency: Very frequent (HP:0040281). (ORPHA:1780)
- Anteverted nares (HP:0000463): Anteriorly-facing nostrils viewed with the head in the Frankfurt horizontal and the eyes of the observer level with the eyes of the subject. This gives the appearance of an upturned nose (upturned nasal tip). Evidence: TAS. Frequency: Very frequent (HP:0040281). (ORPHA:1780)
- Webbed neck (HP:0000465): Pterygium colli is a congenital skin fold that runs along the sides of the neck down to the shoulders. It involves an ectopic fibrotic facial band superficial to the trapezius muscle. Excess hair-bearing skin is also present and extends down the cervical region well beyond the normal hairline. Evidence: TAS. Frequency: Very frequent (HP:0040281). (ORPHA:1780)
- Short neck (HP:0000470): Diminished length of the neck. Evidence: TAS. Frequency: Very frequent (HP:0040281). (ORPHA:1780)
- Upslanted palpebral fissure (HP:0000582): The palpebral fissure inclination is more than two standard deviations above the mean for age (objective); or, the inclination of the palpebral fissure is greater than typical for age. Evidence: TAS. Frequency: Very frequent (HP:0040281). (ORPHA:1780)
- Long palpebral fissure (HP:0000637): Distance between medial and lateral canthi is more than two standard deviations above the mean for age (objective); or, apparently increased length of the palpebral fissures. Evidence: TAS. Frequency: Very frequent (HP:0040281). (ORPHA:1780)
- Congenital diaphragmatic hernia (HP:0000776): The presence of a hernia of the diaphragm present at birth. Evidence: TAS. Frequency: Frequent (HP:0040282). (ORPHA:1780)
- Hypotonia (HP:0001252): Hypotonia is an abnormally low muscle tone (the amount of tension or resistance to movement in a muscle). Even when relaxed, muscles have a continuous and passive partial contraction which provides some resistance to passive stretching. Hypotonia thus manifests as diminished resistance to passive stretching. Hypotonia is not the same as muscle weakness, although the two conditions can co-exist. Evidence: TAS. Frequency: Very frequent (HP:0040281). (ORPHA:1780)
- Agenesis of corpus callosum (HP:0001274): Absence of the corpus callosum as a result of the failure of the corpus callosum to develop, which can be the result of a failure in any one of the multiple steps of callosal development including cellular proliferation and migration, axonal growth or glial patterning at the midline. Evidence: TAS. Frequency: Frequent (HP:0040282). (ORPHA:1780)
- Communicating hydrocephalus (HP:0001334): A form of hydrocephalus in which there is no visible obstruction to the flow of the cerebrospinal fluid between the ventricles and subarachnoid space. Evidence: TAS. Frequency: Frequent (HP:0040282). (ORPHA:1780)
- Intrauterine growth retardation (HP:0001511): An abnormal restriction of fetal growth with fetal weight below the tenth percentile for gestational age. Evidence: TAS. Frequency: Frequent (HP:0040282). (ORPHA:1780)
- Ventricular septal defect (HP:0001629): A hole between the two bottom chambers (ventricles) of the heart. The defect is centered around the most superior aspect of the ventricular septum. Evidence: TAS. Frequency: Frequent (HP:0040282). (ORPHA:1780)
- Tetralogy of Fallot (HP:0001636): A congenital cardiac malformation comprising pulmonary stenosis, overriding aorta, ventricular septum defect, and right ventricular hypertrophy. The diagnosis of TOF is made if at least three of the four above mentioned features are present. Evidence: TAS. Frequency: Frequent (HP:0040282). (ORPHA:1780)
- Transposition of the great arteries (HP:0001669): A complex congenital heart defect in which the aorta arises from the morphologic right ventricle and the pulmonary artery arises from the morphologic left ventricle. Evidence: TAS. Frequency: Frequent (HP:0040282). (ORPHA:1780)
- Anal atresia (HP:0002023): Congenital absence of the anus, i.e., the opening at the bottom end of the intestinal tract. Evidence: TAS. Frequency: Frequent (HP:0040282). (ORPHA:1780)
- Tracheoesophageal fistula (HP:0002575): An abnormal connection (fistula) between the esophagus and the trachea. Evidence: TAS. Frequency: Frequent (HP:0040282). (ORPHA:1780)
- Downturned corners of mouth (HP:0002714): A morphological abnormality of the mouth in which the angle of the mouth is downturned. The oral commissures are positioned inferior to the midline labial fissure. Evidence: TAS. Frequency: Very frequent (HP:0040281). (ORPHA:1780)
- Hemivertebrae (HP:0002937): Absence of one half of the vertebral body. Evidence: TAS. Frequency: Very frequent (HP:0040281). (ORPHA:1780)
- Cervical C2/C3 vertebral fusion (HP:0004602): Fusion of cervical vertebrae at C2 and C3, caused by a failure in the normal segmentation or division of the cervical vertebrae during the early weeks of fetal development, leading to a short neck with a low hairline at the back of the head, and restricted mobility of the upper spine. Evidence: TAS. Frequency: Very frequent (HP:0040281). (ORPHA:1780)
These phenotypes are associated with the disease Thakker-Donnai syndrome (ORPHA:1780).